- Abnormal morphology of the radius (HP:0002818, a Human Phenotype Ontology term): An abnormality of the radius. Evidence: TAS. Frequency: Very frequent (HP:0040281, a Human Phenotype Ontology term). (ORPHA:3269)
- Radioulnar synostosis (HP:0002974, a Human Phenotype Ontology term): An abnormal osseous union (fusion) between the radius and the ulna. Evidence: TAS. Frequency: Very frequent (HP:0040281, a Human Phenotype Ontology term). (ORPHA:3269)
- Limited elbow movement (HP:0002996, a Human Phenotype Ontology term). Evidence: TAS. Frequency: Very frequent (HP:0040281, a Human Phenotype Ontology term). (ORPHA:3269)
- Limited pronation/supination of forearm (HP:0006394, a Human Phenotype Ontology term): A limitation of the ability to place the forearm in a position such that the palm faces anteriorly (supination) and to place the forearm in a position such that the palm faces posteriorly (pronation). Evidence: TAS. Frequency: Very frequent (HP:0040281, a Human Phenotype Ontology term). (ORPHA:3269)
- Abnormal morphology of ulna (HP:0040071, a Human Phenotype Ontology term): Any structural anomaly of the ulna, a bone of the forearm the extends from the elbow to the little finger. Evidence: TAS. Frequency: Very frequent (HP:0040281, a Human Phenotype Ontology term). (ORPHA:3269)
- Abnormality of the musculature of the upper arm (HP:0001457, a Human Phenotype Ontology term). Evidence: TAS. Frequency: Occasional (HP:0040283, a Human Phenotype Ontology term). (ORPHA:3269)
- Dislocated radial head (HP:0003083, a Human Phenotype Ontology term): A dislocation of the head of the radius from its socket in the elbow joint. Evidence: TAS. Frequency: Occasional (HP:0040283, a Human Phenotype Ontology term). (ORPHA:3269)
- Shoulder pain (HP:0030834, a Human Phenotype Ontology term): An unpleasant sensation characterized by physical discomfort (such as pricking, throbbing, or aching) localized to the shoulder. Evidence: TAS. Frequency: Occasional (HP:0040283, a Human Phenotype Ontology term). (ORPHA:3269)
- Wrist pain (HP:0030836, a Human Phenotype Ontology term): An unpleasant sensation characterized by physical discomfort (such as pricking, throbbing, or aching) localized to the wrist. Evidence: TAS. Frequency: Occasional (HP:0040283, a Human Phenotype Ontology term). (ORPHA:3269)
- Syndactyly (HP:0001159, a Human Phenotype Ontology term): Webbing or fusion of the fingers or toes, involving soft parts only or including bone structure. Bony fusions are referred to as "bony" syndactyly if the fusion occurs in a radio-ulnar axis. Fusions of bones of the fingers or toes in a proximo-distal axis are referred to as "symphalangism". Evidence: TAS. Frequency: Very rare (HP:0040284, a Human Phenotype Ontology term). (ORPHA:3269)
- Congenital hip dislocation (HP:0001374, a Human Phenotype Ontology term). Evidence: TAS. Frequency: Very rare (HP:0040284, a Human Phenotype Ontology term). (ORPHA:3269)
- Talipes equinovarus (HP:0001762, a Human Phenotype Ontology term): Talipes equinovarus (also called clubfoot) typically has four main components: inversion and adduction of the forefoot; inversion of the heel and hindfoot; equinus (limitation of extension) of the ankle and subtalar joint; and internal rotation of the leg. Evidence: TAS. Frequency: Very rare (HP:0040284, a Human Phenotype Ontology term). (ORPHA:3269)
- Polydactyly (HP:0010442, a Human Phenotype Ontology term): A congenital anomaly characterized by the presence of supernumerary fingers or toes. Evidence: TAS. Frequency: Very rare (HP:0040284, a Human Phenotype Ontology term). (ORPHA:3269)
These phenotypes are associated with the disease Isolated radio-ulnar synostosis (ORPHA:3269, an Orphanet rare-disease identifier).